- Bilateral tonic-clonic seizure (HP:0002069): A bilateral tonic-clonic seizure is a seizure defined by a tonic (bilateral increased tone, lasting seconds to minutes) and then a clonic (bilateral sustained rhythmic jerking) phase. Evidence: PCS. Frequency: 13/13. (PMID:36074901)
- Juvenile onset (HP:0003621): Onset of signs or symptoms of disease between the age of 5 and 15 years. Evidence: PCS. Frequency: 2/18. (PMID:36074901)
- Delayed speech and language development (HP:0000750): A degree of language development that is significantly below the norm for a child of a specified age. Evidence: PCS. Frequency: 2/2. (PMID:36074901)
- Absent speech (HP:0001344): Complete lack of development of speech and language abilities. Evidence: PCS. Frequency: 4/4. (PMID:36074901)
- Mild intellectual disability (HP:0001256): Mild intellectual disability (ID) is defined as a type of ID characterized by mildly sub-average adaptive functioning and intellectual functioning, with an intelligence quotient (IQ) the range of 50-69. Evidence: PCS. Frequency: 4/4. (PMID:36074901)
- Moderate intellectual disability (HP:0002342): Moderate intellectual disability (ID) is defined as a type of ID characterized by moderately sub-average adaptive functioning and intellectual functioning, with an intelligence quotient (IQ) the range of 35-49. Evidence: PCS. Frequency: 1/1. (PMID:36074901)
- Developmental regression (HP:0002376): Loss of developmental skills, as manifested by loss of developmental milestones. Evidence: PCS. Frequency: 1/1. (PMID:36074901)
- Febrile seizure (within the age range of 3 months to 6 years) (HP:0002373): A febrile seizure is any type of seizure (most often a generalized tonic-clonic seizure) occurring with fever (at least 38 degrees Celsius) but in the absence of central nervous system infection, severe metabolic disturbance or other alternative precipitant in children between the ages of 3 months and 6 years. Evidence: PCS. Frequency: 4/4. (PMID:36074901)
- Focal impaired awareness seizure (HP:0002384): Focal impaired awareness seizure (or focal seizure with impaired or lost awareness) is a type of focal-onset seizure characterized by some degree (which may be partial) of impairment of the person's awareness of themselves or their surroundings at any point during the seizure. Evidence: PCS. Frequency: 2/2. (PMID:36074901)
- Profound intellectual disability (HP:0002187): Profound intellectual disability (ID) is defined as a type of ID characterized by profoundly sub-average adaptive functioning and intellectual functioning, with an intelligence quotient (IQ) below 20. Evidence: PCS. Frequency: 4/4. (PMID:36074901)
- Generalized non-motor (absence) seizure (HP:0002121): A generalized non-motor (absence) seizure is a type of a type of dialeptic seizure that is of electrographically generalized onset. It is a generalized seizure characterized by an interruption of activities, a blank stare, and usually the person will be unresponsive when spoken to. Any ictal motor phenomena are minor in comparison to these non-motor features. Evidence: PCS. Frequency: 6/6. (PMID:36074901)
- Atonic seizure (HP:0010819): Atonic seizure is a type of motor seizure characterized by a sudden loss or diminution of muscle tone without apparent preceding myoclonic or tonic event lasting about 1 to 2 seconds, involving head, trunk, jaw, or limb musculature. Evidence: PCS. Frequency: 6/6. (PMID:36074901)
- Global developmental delay (HP:0001263): A delay in the achievement of motor or mental milestones in the domains of development of a child, including motor skills, speech and language, cognitive skills, and social and emotional skills. This term should only be used to describe children younger than five years of age. Evidence: PCS. Frequency: 21/23. (PMID:36074901)
- Infantile onset (HP:0003593): Onset of signs or symptoms of disease between 28 days to one year of life. Evidence: PCS. Frequency: 8/18. (PMID:36074901)
- Myoclonic seizure (HP:0032794): A myoclonic seizure is a type of motor seizure characterized by sudden, brief (<100 ms) involuntary single or multiple contraction of muscles or muscle groups of variable topography (axial, proximal limb, distal). Myoclonus is less regularly repetitive and less sustained than is clonus. Evidence: PCS. Frequency: 5/5. (PMID:36074901)
- Severe intellectual disability (HP:0010864): Severe intellectual disability (ID) is defined as a type of ID characterized by severely sub-average adaptive functioning and intellectual functioning, with an intelligence quotient (IQ) the range of 20-34. Evidence: PCS. Frequency: 4/4. (PMID:36074901)
- Infantile spasms (HP:0012469): Infantile spasms represent a subset of "epileptic spasms". Infantile Spasms are epileptic spasms starting in the first year of life (infancy). Evidence: PCS. Frequency: 3/3. (PMID:36074901)
- Childhood onset (HP:0011463): Onset of disease at the age of between 1 and 5 years. Evidence: PCS. Frequency: 8/18. (PMID:36074901)
- Tonic seizure (HP:0032792): A tonic seizure is a type of motor seizure characterized by unilateral or bilateral limb stiffening or elevation, often with neck stiffening. Evidence: PCS. Frequency: 4/4. (PMID:36074901)
- Multifocal seizures (HP:0031165): Seizures that start from several different areas of the brain (i.e., with multiple ictal onset locations). Evidence: PCS. Frequency: 1/1. (PMID:36074901)
- Bilateral tonic-clonic seizure with focal onset (HP:0007334): A bilateral tonic-clonic seizure with focal onset is a focal-onset seizure which progresses into a bilateral tonic-clonic phase. Evidence: PCS. Frequency: 2/2. (PMID:36074901)
- Focal-onset seizure (HP:0007359): A focal-onset seizure is a type of seizure originating within networks limited to one hemisphere. They may be discretely localized or more widely distributed, and may originate in subcortical structures. Evidence: PCS. Frequency: 4/4. (PMID:36074901)
- Intellectual disability (HP:0001249): The term intellectual disability or intellectual developmental disorder is used to describe significantly sub-average intellectual and adaptive functioning based on clinical assessment and as measured by individually administered, appropriately normed, standardized and validated tests of intellectual functioning and adaptive behavior, with onset during the developmental period from infancy through adolescence. Evidence: PCS. Frequency: 2/2. (PMID:36074901)
- Autosomal dominant inheritance (HP:0000006): A mode of inheritance that is observed for traits related to a gene encoded on one of the autosomes (i.e., the human chromosomes 1-22) in which a trait manifests in heterozygotes. In the context of medical genetics, an autosomal dominant disorder is caused when a single copy of the mutant allele is present. Males and females are affected equally, and can both transmit the disorder with a risk of 50% for each child of inheriting the mutant allele. Evidence: PCS. (PMID:36074901)
These phenotypes are associated with the disease epilepsy, early-onset, 3, with or without developmental delay (OMIM:620465).